Phenotypes associated with the disease Corpus callosum agenesis-macrocephaly-hypertelorism syndrome (ORPHA:459074):
- Macrocephaly (HP:0000256): Occipitofrontal (head) circumference greater than 97th centile compared to appropriate, age matched, sex-matched normal standards. Alternatively, a apparently increased size of the cranium. Evidence: TAS. Frequency: Very frequent (HP:0040281). (ORPHA:459074)
- Broad forehead (HP:0000337): Width of the forehead or distance between the frontotemporales is more than two standard deviations above the mean (objective); or apparently increased distance between the two sides of the forehead. Evidence: TAS. Frequency: Very frequent (HP:0040281). (ORPHA:459074)
- Agenesis of corpus callosum (HP:0001274): Absence of the corpus callosum as a result of the failure of the corpus callosum to develop, which can be the result of a failure in any one of the multiple steps of callosal development including cellular proliferation and migration, axonal growth or glial patterning at the midline. Evidence: TAS. Frequency: Very frequent (HP:0040281). (ORPHA:459074)
- Hypertelorism (HP:0000316): Interpupillary distance more than 2 SD above the mean (alternatively, the appearance of an increased interpupillary distance or widely spaced eyes). Evidence: TAS. Frequency: Frequent (HP:0040282). (ORPHA:459074)
- Mild intellectual disability (HP:0001256): Mild intellectual disability (ID) is defined as a type of ID characterized by mildly sub-average adaptive functioning and intellectual functioning, with an intelligence quotient (IQ) the range of 50-69. Evidence: TAS. Frequency: Frequent (HP:0040282). (ORPHA:459074)
- Plagiocephaly (HP:0001357): Asymmetric head shape, which is usually a combination of unilateral occipital flattening with ipsilateral frontal prominence, leading to rhomboid cranial shape. Evidence: TAS. Frequency: Frequent (HP:0040282). (ORPHA:459074)
- Chiari type I malformation (HP:0007099): Arnold-Chiari type I malformation refers to a relatively mild degree of herniation of the posteroinferior region of the cerebellum (the cerebellar tonsils) into the cervical canal with little or no displacement of the fourth ventricle. It is characterized by one or both pointed (not rounded) cerebellar tonsils that project 5 mm below the foramen magnum, measured by a line drawn from the basion to the opisthion (McRae Line). Evidence: TAS. Frequency: Frequent (HP:0040282). (ORPHA:459074)
- Facial asymmetry (HP:0000324): An abnormal difference between the left and right sides of the face. Evidence: TAS. Frequency: Occasional (HP:0040283). (ORPHA:459074)
- Generalized-onset seizure (HP:0002197): A generalized-onset seizure is a type of seizure originating at some point within, and rapidly engaging, bilaterally distributed networks. The networks may include cortical and subcortical structures but not necessarily the entire cortex. Evidence: TAS. Frequency: Occasional (HP:0040283). (ORPHA:459074)
- Borderline intellectual disability (HP:0006889): Borderline intellectual disability is defined as an intelligence quotient (IQ) in the range of 70-85. Evidence: TAS. Frequency: Occasional (HP:0040283). (ORPHA:459074)